- Cataract (HP:0000518): A cataract is an opacity or clouding that develops in the crystalline lens of the eye or in its capsule. Evidence: IEA. (OMIM:115800)
- Autosomal dominant inheritance (HP:0000006): A mode of inheritance that is observed for traits related to a gene encoded on one of the autosomes (i.e., the human chromosomes 1-22) in which a trait manifests in heterozygotes. In the context of medical genetics, an autosomal dominant disorder is caused when a single copy of the mutant allele is present. Males and females are affected equally, and can both transmit the disorder with a risk of 50% for each child of inheriting the mutant allele. Evidence: IEA. (OMIM:115800)
These phenotypes are associated with the disease cataract 29 (OMIM:115800).